Phenotypes associated with the disease tibial muscular dystrophy (OMIM:600334):
- Steppage gait (HP:0003376): An abnormal gait pattern that arises from weakness of the pretibial and peroneal muscles due to a lower motor neuron lesion. Affected patients have footdrop and are unable to dorsiflex and evert the foot. The leg is lifted high on walking so that the toes clear the ground, and there may be a slapping noise when the foot strikes the ground again. Evidence: IEA. (OMIM:600334)
- Adult onset (HP:0003581): Onset of disease manifestations in adulthood, defined here as at the age of 16 years or later. Evidence: PCS. Frequency: 71/71. (PMID:12145747)
- Typified by incomplete penetrance (HP:0003829): Description of conditions in which not all individuals with a given genotype exhibit the disease. Penetrance is the proportion that develop disease given a lifespan of 80 years. Evidence: IEA. (OMIM:600334)
- Muscular dystrophy (HP:0003560): The term dystrophy means abnormal growth. However, muscular dystrophy is used to describe primary myopathies with a genetic basis and a progressive course characterized by progressive skeletal muscle weakness and wasting, defects in muscle proteins, and histological features of muscle fiber degeneration (necrosis) and regeneration. If possible, it is preferred to use other HPO terms to describe the precise phenotypic abnormalities. Evidence: TAS. (OMIM:600334)
- Rimmed vacuoles (HP:0003805): Presence of abnormal vacuoles (membrane-bound organelles) in the sarcolemma. On histological staining with hematoxylin and eosin, rimmed vacuoles are popcorn-like clear vacuoles with a densely blue rim. The vacuoles are often associated with cytoplasmic and occasionally intranuclear eosinophilic inclusions. Evidence: TAS. (OMIM:600334)
- Cardiomyopathy (HP:0001638): A myocardial disorder in which the heart muscle is structurally and functionally abnormal, in the absence of coronary artery disease, hypertension, valvular disease and congenital heart disease sufficient to cause the observed myocardial abnormality. Evidence: PCS. Frequency: 0/71. (PMID:12145747)
- Tibialis muscle weakness (HP:0008963): Muscle weakness affecting the tibialis anterior muscle. Evidence: PCS. Frequency: 71/71. (PMID:12145747)
- Tibialis anterior muscle atrophy (HP:0011399): Wasting of the tibialis anterior muscle. Evidence: PCS. Frequency: 71/71. (PMID:12145747)
- Autosomal dominant inheritance (HP:0000006): A mode of inheritance that is observed for traits related to a gene encoded on one of the autosomes (i.e., the human chromosomes 1-22) in which a trait manifests in heterozygotes. In the context of medical genetics, an autosomal dominant disorder is caused when a single copy of the mutant allele is present. Males and females are affected equally, and can both transmit the disorder with a risk of 50% for each child of inheriting the mutant allele. Evidence: PCS. (PMID:12145747)
- Slowly progressive (HP:0003677): Applies to a disease manifestation that only slowly increases in scope or severity over the course of time. Evidence: TAS. (OMIM:600334)
- EMG: myopathic abnormalities (HP:0003458): The presence of abnormal electromyographic patterns indicative of myopathy, such as small-short polyphasic motor unit potentials. Evidence: IEA. (OMIM:600334)